- Atrioventricular block (HP:0001678): Delayed or lack of conduction of atrial depolarizations through the atrioventricular node to the ventricles. Evidence: TAS. Frequency: Obligate (HP:0040280). (ORPHA:60041)
- Third degree atrioventricular block (HP:0001709): Third-degree atrioventricular (AV) block (also referred to as complete heart block) is the complete dissociation of the atria and the ventricles. Third-degree AV block exists when more P waves than QRS complexes exist and no relationship (no conduction) exists between them. Evidence: TAS. Frequency: Very frequent (HP:0040281). (ORPHA:60041)
- Premature birth (HP:0001622): The birth of a baby of less than 37 weeks of gestational age. Evidence: TAS. Frequency: Frequent (HP:0040282). (ORPHA:60041)
- Vaginal birth after Caesarean (HP:0030365): Vaginal birth after Caesarean (VBAC) refers to the situation where the mother has had a previous Cesarean delivery but has now delivered vaginally. Evidence: TAS. Frequency: Frequent (HP:0040282). (ORPHA:60041)
- Cyanosis (HP:0000961): Bluish discoloration of the skin and mucosa due to poor circulation or inadequate oxygenation of arterial or capillary blood. Evidence: TAS. Frequency: Occasional (HP:0040283). (ORPHA:60041)
- Hyperhidrosis (HP:0000975): Abnormal excessive perspiration (sweating) despite the lack of appropriate stimuli like hot and humid weather. Evidence: TAS. Frequency: Occasional (HP:0040283). (ORPHA:60041)
- Pallor (HP:0000980): Abnormally pale skin. Evidence: TAS. Frequency: Occasional (HP:0040283). (ORPHA:60041)
- Syncope (HP:0001279): A transient loss of consciousness (i.e., characterized by a rapid onset, a short duration, and a spontaneous and complete recovery) due to cerebral hypoperfusion. Evidence: TAS. Frequency: Occasional (HP:0040283). (ORPHA:60041)
- Intrauterine growth retardation (HP:0001511): An abnormal restriction of fetal growth with fetal weight below the tenth percentile for gestational age. Evidence: TAS. Frequency: Occasional (HP:0040283). (ORPHA:60041)
- Oligohydramnios (HP:0001562): Diminished amniotic fluid volume in pregnancy. Evidence: TAS. Frequency: Occasional (HP:0040283). (ORPHA:60041)
- Weak cry (HP:0001612). Evidence: TAS. Frequency: Occasional (HP:0040283). (ORPHA:60041)
- Congestive heart failure (HP:0001635): The presence of an abnormality of cardiac function that is responsible for the failure of the heart to pump blood at a rate that is commensurate with the needs of the tissues or a state in which abnormally elevated filling pressures are required for the heart to do so. Heart failure is frequently related to a defect in myocardial contraction. Evidence: TAS. Frequency: Occasional (HP:0040283). (ORPHA:60041)
- Patent ductus arteriosus (HP:0001643): In utero, the ductus arteriosus (DA) serves to divert ventricular output away from the lungs and toward the placenta by connecting the main pulmonary artery to the descending aorta. A patent ductus arteriosus (PDA) in the first 3 days of life is a physiologic shunt in healthy term and preterm newborn infants, and normally is substantially closed within about 24 hours after bith and completely closed after about three weeks. Failure of physiologcal closure is referred to a persistent or patent ductus arteriosus (PDA). Depending on the degree of left-to-right shunting, PDA can have clinical consequences. Evidence: TAS. Frequency: Occasional (HP:0040283). (ORPHA:60041)
- Patent foramen ovale (HP:0001655): Failure of the foramen ovale to seal postnatally, leaving a potential conduit between the left and right cardiac atria. Evidence: TAS. Frequency: Occasional (HP:0040283). (ORPHA:60041)
- Bradycardia (HP:0001662): A slower than normal heart rate (in adults, slower than 60 beats per minute). Evidence: TAS. Frequency: Occasional (HP:0040283). (ORPHA:60041)
- Pericardial effusion (HP:0001698): Accumulation of fluid within the pericardium. Evidence: TAS. Frequency: Occasional (HP:0040283). (ORPHA:60041)
- Hydrops fetalis (HP:0001789): The abnormal accumulation of fluid in two or more fetal compartments, including ascites, pleural effusion, pericardial effusion, and skin edema. Evidence: TAS. Frequency: Occasional (HP:0040283). (ORPHA:60041)
- Exercise intolerance (HP:0003546): A functional motor deficit where individuals whose responses to the challenges of exercise fail to achieve levels considered normal for their age and gender. Evidence: TAS. Frequency: Occasional (HP:0040283). (ORPHA:60041)
- Prolonged QTc interval (HP:0005184): A longer than normal interval (corrected for heart rate) between the Q and T waves in the heart's cycle. Prolonged QTc can cause premature action potentials during late phase depolarizations thereby leading to ventricular arrhythmias and ventricular fibrillations. Evidence: TAS. Frequency: Occasional (HP:0040283). (ORPHA:60041)
- Feeding difficulties in infancy (HP:0008872): Impaired feeding performance of an infant as manifested by difficulties such as weak and ineffective sucking, brief bursts of sucking, and falling asleep during sucking. There may be difficulties with chewing or maintaining attention. Evidence: TAS. Frequency: Occasional (HP:0040283). (ORPHA:60041)
- Second degree atrioventricular block (HP:0011706): An intermittent atrioventricular block with failure of some atrial impulses to conduct to the ventricles, i.e., some but not all atrial impulses are conducted through the atrioventricular node and trigger ventricular contraction. Evidence: TAS. Frequency: Occasional (HP:0040283). (ORPHA:60041)
- Fatigue (HP:0012378): A subjective feeling of tiredness characterized by a lack of energy and motivation. Evidence: TAS. Frequency: Occasional (HP:0040283). (ORPHA:60041)
- Peripheral edema (HP:0012398): An abnormal accumulation of interstitial fluid in the soft tissues of the limbs. Evidence: TAS. Frequency: Occasional (HP:0040283). (ORPHA:60041)
- Crackles (HP:0030830): Crackles are discontinuous, explosive, and nonmusical adventitious lung sounds normally heard in inspiration and sometimes during expiration. Crackles are usually classified as fine and coarse crackles based on their duration, loudness, pitch, timing in the respiratory cycle, and relationship to coughing and changing body position. Evidence: TAS. Frequency: Occasional (HP:0040283). (ORPHA:60041)
- Gallop rhythm (HP:0033113): In the normal heart cycle, two heart sounds can be heard by auscultation per cycle: S1 and S2. A gallop rhythm refers to the presence of three or four heart sounds per cardiac cycle, which is said to resemble the gallop of a horse. Evidence: TAS. Frequency: Occasional (HP:0040283). (ORPHA:60041)
- Endocardial fibroelastosis (HP:0001706): Diffuse thickening of the ventricular endocardium and by associated myocardial dysfunction. Evidence: TAS. Frequency: Very rare (HP:0040284). (ORPHA:60041)
- Pleural effusion (HP:0002202): The presence of an excessive amount of fluid in the pleural cavity. Evidence: TAS. Frequency: Very rare (HP:0040284). (ORPHA:60041)
- First degree atrioventricular block (HP:0011705): Delay of conduction through the atrioventricular node, which is manifested as prolongation of the PR interval in the electrocardiogram (EKG). All atrial impulses reach the ventricles. Evidence: TAS. Frequency: Very rare (HP:0040284). (ORPHA:60041)
- Abnormal heart valve physiology (HP:0031653): Any functional abnormality of a cardiac valve. Evidence: TAS. Frequency: Very rare (HP:0040284). (ORPHA:60041)
These phenotypes are associated with the disease Congenital heart block (ORPHA:60041).